Phenotypes associated with the disease 3MC syndrome (ORPHA:293843):
- Hearing impairment (HP:0000365): A decreased magnitude of the sensory perception of sound. Evidence: TAS. Frequency: Very frequent (HP:0040281). (ORPHA:293843)
- Ptosis (HP:0000508): The upper eyelid margin is positioned 3 mm or more lower than usual and covers the superior portion of the iris (objective); or, the upper lid margin obscures at least part of the pupil (subjective). Evidence: TAS. Frequency: Very frequent (HP:0040281). (ORPHA:293843)
- Epicanthus inversus (HP:0000537): A fold of skin starting at or just below the medial aspect of the lower lid and arching upward to cover, extend in front of and lateral to the medial canthus. Evidence: TAS. Frequency: Very frequent (HP:0040281). (ORPHA:293843)
- Highly arched eyebrow (HP:0002553): Increased height of the central portion of the eyebrow, forming a crescent, semicircular, or inverted U shape. Evidence: TAS. Frequency: Very frequent (HP:0040281). (ORPHA:293843)
- Radioulnar synostosis (HP:0002974): An abnormal osseous union (fusion) between the radius and the ulna. Evidence: TAS. Frequency: Very frequent (HP:0040281). (ORPHA:293843)
- Limited pronation/supination of forearm (HP:0006394): A limitation of the ability to place the forearm in a position such that the palm faces anteriorly (supination) and to place the forearm in a position such that the palm faces posteriorly (pronation). Evidence: TAS. Frequency: Very frequent (HP:0040281). (ORPHA:293843)
- Orofacial cleft (HP:0000202): The presence of a cleft (gap, opening, or groove) in the oral cavity, including cleft of the upper lip and/or cleft of the palate. Cleft of the upper lip is visible as a groove or fissure in the lip, most frequently due to a congenital failure of the maxillary and median nasal processes to fuse. Cleft palate is characterized by a grooved depression or fissure in the roof of the mouth, most often resulting from a congenital failure of the palate to fuse properly. Clefts of the lip and palate can occur individually or together. It is preferable to code each defect separately. Evidence: TAS. Frequency: Frequent (HP:0040282). (ORPHA:293843)
- Hypertelorism (HP:0000316): Interpupillary distance more than 2 SD above the mean (alternatively, the appearance of an increased interpupillary distance or widely spaced eyes). Evidence: TAS. Frequency: Frequent (HP:0040282). (ORPHA:293843)
- Downslanted palpebral fissures (HP:0000494): The palpebral fissure inclination is more than two standard deviations below the mean. Evidence: TAS. Frequency: Frequent (HP:0040282). (ORPHA:293843)
- Telecanthus (HP:0000506): Distance between the inner canthi more than two standard deviations above the mean (objective); or, apparently increased distance between the inner canthi. Evidence: TAS. Frequency: Frequent (HP:0040282). (ORPHA:293843)
- Blepharophimosis (HP:0000581): A fixed reduction in the vertical distance between the upper and lower eyelids with short palpebral fissures. Evidence: TAS. Frequency: Frequent (HP:0040282). (ORPHA:293843)
- Abnormal anterior chamber morphology (HP:0000593): Abnormality of the anterior chamber, which is the space in the eye that is behind the cornea and in front of the iris. Evidence: TAS. Frequency: Frequent (HP:0040282). (ORPHA:293843)
- Intellectual disability (HP:0001249): The term intellectual disability or intellectual developmental disorder is used to describe significantly sub-average intellectual and adaptive functioning based on clinical assessment and as measured by individually administered, appropriately normed, standardized and validated tests of intellectual functioning and adaptive behavior, with onset during the developmental period from infancy through adolescence. Evidence: TAS. Frequency: Frequent (HP:0040282). (ORPHA:293843)
- Craniosynostosis (HP:0001363): Craniosynostosis refers to the premature closure of the cranial sutures. Primary craniosynostosis refers to the closure of one or more sutures due to abnormalities in skull development, and secondary craniosynostosis results from failure of brain growth. Evidence: TAS. Frequency: Frequent (HP:0040282). (ORPHA:293843)
- Diastasis recti (HP:0001540): A separation of the rectus abdominis muscle into right and left halves (which are normally joined at the midline at the linea alba). Evidence: TAS. Frequency: Frequent (HP:0040282). (ORPHA:293843)
- Large fleshy ears (HP:0002265). Evidence: TAS. Frequency: Frequent (HP:0040282). (ORPHA:293843)
- Supernumerary nipple (HP:0002558): Presence of more than two nipples. Evidence: TAS. Frequency: Frequent (HP:0040282). (ORPHA:293843)
- Scoliosis (HP:0002650): The presence of an abnormal lateral curvature of the spine. Evidence: TAS. Frequency: Frequent (HP:0040282). (ORPHA:293843)
- Downturned corners of mouth (HP:0002714): A morphological abnormality of the mouth in which the angle of the mouth is downturned. The oral commissures are positioned inferior to the midline labial fissure. Evidence: TAS. Frequency: Frequent (HP:0040282). (ORPHA:293843)
- Spina bifida occulta (HP:0003298): The closed form of spina bifida with incomplete closure of a vertebral body with intact overlying skin. Evidence: TAS. Frequency: Frequent (HP:0040282). (ORPHA:293843)
- Hyperlordosis (HP:0003307): Abnormally increased curvature (anterior concavity) of the lumbar or cervical spine. Evidence: TAS. Frequency: Frequent (HP:0040282). (ORPHA:293843)
- Bilateral cryptorchidism (HP:0008689): Absence of both testes from the scrotum owing to failure of the testis or testes to descend through the inguinal canal to the scrotum. Evidence: TAS. Frequency: Frequent (HP:0040282). (ORPHA:293843)
- Postnatal growth retardation (HP:0008897): Slow or limited growth after birth. Evidence: TAS. Frequency: Frequent (HP:0040282). (ORPHA:293843)
- Low-set ears (HP:0000369): Upper insertion of the ear to the scalp below an imaginary horizontal line drawn between the inner canthi of the eye and extending posteriorly to the ear. Evidence: TAS. Frequency: Occasional (HP:0040283). (ORPHA:293843)
- Abnormal pinna morphology (HP:0000377): An abnormality of the pinna, which is also referred to as the auricle or external ear. Evidence: TAS. Frequency: Occasional (HP:0040283). (ORPHA:293843)
- Umbilical hernia (HP:0001537): Protrusion of abdominal contents through a defect in the abdominal wall musculature around the umbilicus. Skin and subcutaneous tissue overlie the defect. Evidence: TAS. Frequency: Occasional (HP:0040283). (ORPHA:293843)
- Caudal appendage (HP:0002825): The presence of a tail-like skin appendage located adjacent to the sacrum. Evidence: TAS. Frequency: Occasional (HP:0040283). (ORPHA:293843)
- Hip dislocation (HP:0002827): Displacement of the femur from its normal location in the hip joint. Evidence: TAS. Frequency: Occasional (HP:0040283). (ORPHA:293843)
- Abnormal nasal morphology (HP:0005105). Evidence: TAS. Frequency: Occasional (HP:0040283). (ORPHA:293843)
- Prominent coccyx (HP:0040016). Evidence: TAS. Frequency: Occasional (HP:0040283). (ORPHA:293843)